- Abnormal bleeding (HP:0001892): An abnormal susceptibility to bleeding, often referred to as a bleeding diathesis. A bleeding diathesis may be related to vascular, platelet and coagulation defects. Evidence: IEA. (OMIM:169200)
- Autosomal dominant inheritance (HP:0000006): A mode of inheritance that is observed for traits related to a gene encoded on one of the autosomes (i.e., the human chromosomes 1-22) in which a trait manifests in heterozygotes. In the context of medical genetics, an autosomal dominant disorder is caused when a single copy of the mutant allele is present. Males and females are affected equally, and can both transmit the disorder with a risk of 50% for each child of inheriting the mutant allele. Evidence: IEA. (OMIM:169200)
These phenotypes are associated with the disease Pechet factor deficiency (OMIM:169200).